Phenotypes associated with the disease left ventricular noncompaction 7 (OMIM:615092):
- Left ventricular noncompaction (HP:0030682): Left ventricular noncompaction (LVNC) is defined by 3 markers: prominent left ventricular (LV) trabeculae, deep intertrabecular recesses, and the thin compacted layer. Evidence: PCS. (PMID:23314057)
- Left ventricular noncompaction cardiomyopathy (HP:0011664): Left ventricular non-compaction (LVNC) is characterized by prominent left ventricular trabeculae and deep inter-trabecular recesses. The myocardial wall is often thickened with a thin, compacted epicardial layer and a thickened endocardial layer. In some patients, LVNC is associated with left ventricular dilatation and systolic dysfunction, which can be transient in neonates. Evidence: PCS. (PMID:23314057)
- Autosomal dominant inheritance (HP:0000006): A mode of inheritance that is observed for traits related to a gene encoded on one of the autosomes (i.e., the human chromosomes 1-22) in which a trait manifests in heterozygotes. In the context of medical genetics, an autosomal dominant disorder is caused when a single copy of the mutant allele is present. Males and females are affected equally, and can both transmit the disorder with a risk of 50% for each child of inheriting the mutant allele. Evidence: PCS. (PMID:23314057)